- Medullary thyroid carcinoma (HP:0002865): The presence of a medullary carcinoma of the thyroid gland. Evidence: IEA. (OMIM:155240)
- Autosomal dominant inheritance (HP:0000006): A mode of inheritance that is observed for traits related to a gene encoded on one of the autosomes (i.e., the human chromosomes 1-22) in which a trait manifests in heterozygotes. In the context of medical genetics, an autosomal dominant disorder is caused when a single copy of the mutant allele is present. Males and females are affected equally, and can both transmit the disorder with a risk of 50% for each child of inheriting the mutant allele. Evidence: IEA. (OMIM:155240)
These phenotypes are associated with the disease familial medullary thyroid carcinoma (OMIM:155240).